Phenotypes associated with the disease neurodevelopmental disorder with eye movement abnormalities and ataxia (OMIM:620094):
- Strabismus (HP:0000486): A misalignment of the eyes so that the visual axes deviate from bifoveal fixation. The classification of strabismus may be based on a number of features including the relative position of the eyes, whether the deviation is latent or manifest, intermittent or constant, concomitant or otherwise and according to the age of onset and the relevance of any associated refractive error. Evidence: PCS. Frequency: 1/8. (PMID:36206744)
- Delayed CNS myelination (HP:0002188): Delayed myelination in the central nervous system. Evidence: PCS. Frequency: 1/8. (PMID:36206744)
- Dystonia (HP:0001332): An abnormally increased muscular tone that causes fixed abnormal postures. There is a slow, intermittent twisting motion that leads to exaggerated turning and posture of the extremities and trunk. Evidence: PCS. Frequency: 2/8. (PMID:36206744)
- Seizure (HP:0001250): A seizure is an intermittent abnormality of nervous system physiology characterized by a transient occurrence of signs and/or symptoms due to abnormal excessive or synchronous neuronal activity in the brain. Evidence: PCS. Frequency: 5/8. (PMID:36206744)
- Hypotonia (HP:0001252): Hypotonia is an abnormally low muscle tone (the amount of tension or resistance to movement in a muscle). Even when relaxed, muscles have a continuous and passive partial contraction which provides some resistance to passive stretching. Hypotonia thus manifests as diminished resistance to passive stretching. Hypotonia is not the same as muscle weakness, although the two conditions can co-exist. Evidence: PCS. Frequency: 5/7. (PMID:36206744)
- Urinary incontinence (HP:0000020): Loss of the ability to control the urinary bladder leading to involuntary urination. Evidence: PCS. Frequency: 1/8. (PMID:36206744)
- Infantile onset (HP:0003593): Onset of signs or symptoms of disease between 28 days to one year of life. Evidence: PCS. Frequency: 3/8. (PMID:36206744)
- Ataxia (HP:0001251): Ataxia refers to impaired coordination of voluntary muscle movement. Cerebellar ataxia refers to ataxia due to dysfunction of the cerebellum. This causes a variety of elementary neurological deficits including asynergy (lack of coordination between muscles, limbs and joints), dysmetria (lack of ability to judge distances that can lead to under- or overshoot in grasping movements), and dysdiadochokinesia (inability to perform rapid movements requiring antagonizing muscle groups to be switched on and off repeatedly). Evidence: PCS. Frequency: 7/8. (PMID:36206744)
- Dyslexia (HP:0010522): A learning disorder characterized primarily by difficulties in learning to read and spell. Dyslectic children also exhibit a tendency to read words from right to left and to confuse letters such as b and d whose orientation is important for their identification. Children with dyslexia appear to be impaired in phonemic skills (the ability to associate visual symbols with the sounds they represent). Evidence: PCS. Frequency: 1/8. (PMID:36206744)
- Opsoclonus (HP:0010543): Bursts of large-amplitude multidirectional saccades without intersaccadic interval. Evidence: PCS. Frequency: 3/8. (PMID:36206744)
- Motor delay (HP:0001270): A type of Developmental delay characterized by a delay in acquiring motor skills. Evidence: PCS. Frequency: 8/8. (PMID:36206744)
- Nystagmus (HP:0000639): Rhythmic, involuntary oscillations of one or both eyes related to abnormality in fixation, conjugate gaze, or vestibular mechanisms. Evidence: PCS. Frequency: 4/8. (PMID:36206744)
- Anxiety (HP:0000739): Intense feelings of nervousness, tension, or panic often arise in response to interpersonal stresses. There is worry about the negative effects of past unpleasant experiences and future negative possibilities. Individuals may feel fearful, apprehensive, or threatened by uncertainty, and they may also have fears of falling apart or losing control. Evidence: PCS. Frequency: 1/8. (PMID:36206744)
- Pachygyria (HP:0001302): Pachygyria is a malformation of cortical development with abnormally wide gyri with sulci 1,5-3 cm apart and abnormally thick cortex measuring more than 5 mm (radiological definition). See also neuropathological definitions for 2-, 3-, and 4-layered lissencephaly. Evidence: PCS. Frequency: 1/8. (PMID:36206744)
- Constipation (HP:0002019): Infrequent or difficult evacuation of feces. Evidence: PCS. Frequency: 1/8. (PMID:36206744)
- Intellectual disability (HP:0001249): The term intellectual disability or intellectual developmental disorder is used to describe significantly sub-average intellectual and adaptive functioning based on clinical assessment and as measured by individually administered, appropriately normed, standardized and validated tests of intellectual functioning and adaptive behavior, with onset during the developmental period from infancy through adolescence. Evidence: PCS. Frequency: 7/7. (PMID:36206744)
- Neonatal onset (HP:0003623): Onset of signs or symptoms of disease within the first 28 days of life. Evidence: PCS. Frequency: 5/8. (PMID:36206744)
- Feeding difficulties (HP:0011968): Impaired ability to eat related to problems gathering food and getting ready to suck, chew, or swallow it. Evidence: PCS. Frequency: 2/8. (PMID:36206744)
- Migraine (HP:0002076): Migraine is a chronic neurological disorder characterized by episodic attacks of headache and associated symptoms. Evidence: PCS. Frequency: 1/8. (PMID:36206744)
- Global developmental delay (HP:0001263): A delay in the achievement of motor or mental milestones in the domains of development of a child, including motor skills, speech and language, cognitive skills, and social and emotional skills. This term should only be used to describe children younger than five years of age. Evidence: PCS. Frequency: 8/8. (PMID:36206744)
- Esotropia (HP:0000565): A form of strabismus with one or both eyes turned inward ('crossed') to a relatively severe degree, usually defined as 10 diopters or more. Evidence: PCS. Frequency: 1/8. (PMID:36206744)
- Spasticity (HP:0001257): A motor disorder characterized by a velocity-dependent increase in tonic stretch reflexes with increased muscle tone, exaggerated (hyperexcitable) tendon reflexes. Evidence: PCS. Frequency: 4/7. (PMID:36206744)
- Atrial septal defect (HP:0001631): Atrial septal defect (ASD) is a congenital abnormality of the interatrial septum that enables blood flow between the left and right atria via the interatrial septum. Evidence: PCS. Frequency: 1/8. (PMID:36206744)
- Autosomal dominant inheritance (HP:0000006): A mode of inheritance that is observed for traits related to a gene encoded on one of the autosomes (i.e., the human chromosomes 1-22) in which a trait manifests in heterozygotes. In the context of medical genetics, an autosomal dominant disorder is caused when a single copy of the mutant allele is present. Males and females are affected equally, and can both transmit the disorder with a risk of 50% for each child of inheriting the mutant allele. Evidence: PCS. (PMID:36206744)
- Myoclonus (HP:0001336): Very brief, involuntary random muscular contractions occurring at rest, in response to sensory stimuli, or accompanying voluntary movements. Evidence: PCS. Frequency: 1/8. (PMID:36206744)